Phenotypes associated with the disease Alfadhel syndrome (OMIM:620655):
- Bilateral tonic-clonic seizure (HP:0002069): A bilateral tonic-clonic seizure is a seizure defined by a tonic (bilateral increased tone, lasting seconds to minutes) and then a clonic (bilateral sustained rhythmic jerking) phase. Evidence: PCS. Frequency: 1/3. (PMID:32431071)
- Delayed CNS myelination (HP:0002188): Delayed myelination in the central nervous system. Evidence: PCS. Frequency: 1/1. (PMID:33875846)
- Short stature (HP:0004322): A height below that which is expected according to age and gender norms. Although there is no universally accepted definition of short stature, many refer to "short stature" as height more than 2 standard deviations below the mean for age and gender (or below the 3rd percentile for age and gender dependent norms). Evidence: PCS. Frequency: 1/1. (PMID:33875846)
- Seizure (HP:0001250): A seizure is an intermittent abnormality of nervous system physiology characterized by a transient occurrence of signs and/or symptoms due to abnormal excessive or synchronous neuronal activity in the brain. Evidence: PCS. Frequency: 0/1. (PMID:32431071)
- Horseshoe kidney (HP:0000085): A connection of the right and left kidney by an isthmus of functioning renal parenchyma or fibrous tissue that crosses the midline. Evidence: PCS. Frequency: 1/4. (PMID:32431071)
- Infantile onset (HP:0003593): Onset of signs or symptoms of disease between 28 days to one year of life. Evidence: PCS. Frequency: 3/4. (PMID:32431071)
- Receptive language delay (HP:0010863): A delay in the acquisition of the ability to understand the speech of others. Evidence: PCS. Frequency: 0/4. (PMID:32431071)
- Motor delay (HP:0001270): A type of Developmental delay characterized by a delay in acquiring motor skills. Evidence: PCS. Frequency: 5/5. (PMID:33875846;PMID:32431071)
- Smooth philtrum (HP:0000319): Flat skin surface, with no ridge formation in the central region of the upper lip between the nasal base and upper vermilion border. Evidence: PCS. Frequency: 3/3. (PMID:32431071)
- Aggressive behavior (HP:0000718): Behavior or an act aimed at harming a person, animal, or physical property (e.g., acts of physical violence; shouting, swearing, and using harsh language; slashing someone's tires). Evidence: PCS. Frequency: 1/1. (PMID:32431071)
- Hypertelorism (HP:0000316): Interpupillary distance more than 2 SD above the mean (alternatively, the appearance of an increased interpupillary distance or widely spaced eyes). Evidence: PCS. Frequency: 1/1. (PMID:33875846)
- Bulbous nose (HP:0000414): Increased volume and globular shape of the anteroinferior aspect of the nose. Evidence: PCS. Frequency: 3/3. (PMID:32431071)
- Retrognathia (HP:0000278): An abnormality in which the mandible is mislocalised posteriorly. Evidence: PCS. Frequency: 4/4. (PMID:32431071)
- Intellectual disability (HP:0001249): The term intellectual disability or intellectual developmental disorder is used to describe significantly sub-average intellectual and adaptive functioning based on clinical assessment and as measured by individually administered, appropriately normed, standardized and validated tests of intellectual functioning and adaptive behavior, with onset during the developmental period from infancy through adolescence. Evidence: PCS. Frequency: 4/4. (PMID:32431071)
- Neonatal onset (HP:0003623): Onset of signs or symptoms of disease within the first 28 days of life. Evidence: PCS. Frequency: 1/4. (PMID:32431071)
- Axial hypotonia (HP:0008936): Muscular hypotonia (abnormally low muscle tone) affecting the musculature of the trunk. Evidence: PCS. Frequency: 5/5. (PMID:33875846;PMID:32431071)
- Highly arched eyebrow (HP:0002553): Increased height of the central portion of the eyebrow, forming a crescent, semicircular, or inverted U shape. Evidence: PCS. Frequency: 3/3. (PMID:33875846;PMID:32431071)
- Hyporeflexia (HP:0001265): Reduction of neurologic reflexes such as the knee-jerk reaction. Evidence: PCS. Frequency: 2/2. (PMID:32431071)
- Microcephaly (HP:0000252): Head circumference below 2 standard deviations below the mean for age and gender. Evidence: PCS. Frequency: 1/1. (PMID:33875846)
- Nasal flaring (HP:0030863): Widening of the nostrils upon inhalation as a manifestation of respiratory distress. Evidence: PCS. Frequency: 1/1. (PMID:33875846)
- Thin vermilion border (HP:0000233): Height of the vermilion of the medial part of the lip more than 2 SD below the mean, or apparently reduced height of the vermilion of the lip in the frontal view. The vermilion is the red part of the lips (and confusingly, the vermilion itself is also often referred to as being equivalent the lips). Evidence: PCS. Frequency: 2/2. (PMID:32431071)
- Expressive language delay (HP:0002474): A delay in the acquisition of the ability to use language to communicate needs, wishes, or thoughts. Evidence: PCS. Frequency: 4/4. (PMID:32431071)
- Talipes equinovarus (HP:0001762): Talipes equinovarus (also called clubfoot) typically has four main components: inversion and adduction of the forefoot; inversion of the heel and hindfoot; equinus (limitation of extension) of the ankle and subtalar joint; and internal rotation of the leg. Evidence: PCS. Frequency: 2/4. (PMID:32431071)
- Joint hypermobility (HP:0001382): The capability that a joint (or a group of joints) has to move, passively and/or actively, beyond normal limits along physiological axes. Evidence: PCS. Frequency: 1/1. (PMID:33875846)
- Global developmental delay (HP:0001263): A delay in the achievement of motor or mental milestones in the domains of development of a child, including motor skills, speech and language, cognitive skills, and social and emotional skills. This term should only be used to describe children younger than five years of age. Evidence: PCS. Frequency: 5/5. (PMID:33875846;PMID:32431071)
- High forehead (HP:0000348): An abnormally increased height of the forehead. Evidence: PCS. Frequency: 1/1. (PMID:33875846)
- Autosomal recessive inheritance (HP:0000007): A mode of inheritance that is observed for traits related to a gene encoded on one of the autosomes (i.e., the human chromosomes 1-22) in which a trait manifests in individuals with two pathogenic alleles, either homozygotes (two copies of the same mutant allele) or compound heterozygotes (whereby each copy of a gene has a distinct mutant allele). Evidence: PCS. (PMID:32431071)
- Spastic paraplegia (HP:0001258): Complete loss of the ability to move the lower limbs accompanied by spasticity of the lower limbs. Evidence: PCS. Frequency: 1/1. (PMID:33875846)
- Short philtrum (HP:0000322): Distance between nasal base and midline upper lip vermilion border more than 2 SD below the mean. Alternatively, an apparently decreased distance between nasal base and midline upper lip vermilion border. Evidence: PCS. Frequency: 2/2. (PMID:32431071)
- Low-set ears (HP:0000369): Upper insertion of the ear to the scalp below an imaginary horizontal line drawn between the inner canthi of the eye and extending posteriorly to the ear. Evidence: PCS. Frequency: 1/1. (PMID:33875846)
- Triangular face (HP:0000325): Facial contour, as viewed from the front, triangular in shape, with breadth at the temples and tapering to a narrow chin. Evidence: PCS. Frequency: 2/2. (PMID:32431071)